- Dysphagia (HP:0002015): Difficulty in swallowing. Evidence: PCS. Frequency: 1/7. (PMID:28886343)
- Delayed speech and language development (HP:0000750): A degree of language development that is significantly below the norm for a child of a specified age. Evidence: PCS. Frequency: 1/7. (PMID:28886343)
- Dysmetria (HP:0001310): A type of ataxia characterized by the inability to carry out movements with the correct range and motion across the plane of more than one joint related to incorrect estimation of the distances required for targeted movements. Evidence: PCS. Frequency: 2/2. (PMID:28886343)
- Cerebellar atrophy (HP:0001272): Cerebellar atrophy is defined as a cerebellum with initially normal structures, in a posterior fossa with normal size, which displays enlarged fissures (interfolial spaces) in comparison to the foliae secondary to loss of tissue. Cerebellar atrophy implies irreversible loss of tissue and result from an ongoing progressive disease until a final stage is reached or a single injury, e.g. an intoxication or infectious event. Evidence: PCS. Frequency: 3/3. (PMID:28886343)
- Dysarthria (HP:0001260): Dysarthric speech is a general description referring to a neurological speech disorder characterized by poor articulation. Depending on the involved neurological structures, dysarthria may be further classified as spastic, flaccid, ataxic, hyperkinetic and hypokinetic, or mixed. Evidence: PCS. Frequency: 1/7. (PMID:28886343)
- Gait ataxia (HP:0002066): A type of ataxia characterized by the impairment of the ability to coordinate the movements required for normal walking. Gait ataxia is characteirzed by a wide-based staggering gait with a tendency to fall. Evidence: PCS. Frequency: 3/3. (PMID:28886343)
- Ataxia (HP:0001251): Ataxia refers to impaired coordination of voluntary muscle movement. Cerebellar ataxia refers to ataxia due to dysfunction of the cerebellum. This causes a variety of elementary neurological deficits including asynergy (lack of coordination between muscles, limbs and joints), dysmetria (lack of ability to judge distances that can lead to under- or overshoot in grasping movements), and dysdiadochokinesia (inability to perform rapid movements requiring antagonizing muscle groups to be switched on and off repeatedly). Evidence: PCS. Frequency: 7/7. (PMID:28886343)
- Dysdiadochokinesis (HP:0002075): A type of ataxia characterized by the impairment of the ability to perform rapidly alternating movements, such as pronating and supinating his or her hand on the dorsum of the other hand as rapidly as possible. Evidence: PCS. Frequency: 2/2. (PMID:28886343)
- Tinnitus (HP:0000360): Tinnitus is an auditory perception that can be described as the experience of sound, in the ear or in the head, in the absence of external acoustic stimulation. Evidence: PCS. Frequency: 3/7. (PMID:28886343)
- Motor delay (HP:0001270): A type of Developmental delay characterized by a delay in acquiring motor skills. Evidence: PCS. Frequency: 1/7. (PMID:28886343)
- Frequent falls (HP:0002359). Evidence: PCS. Frequency: 3/7. (PMID:28886343)
- Spasticity (HP:0001257): A motor disorder characterized by a velocity-dependent increase in tonic stretch reflexes with increased muscle tone, exaggerated (hyperexcitable) tendon reflexes. Evidence: PCS. Frequency: 1/7. (PMID:28886343)
- Autosomal dominant inheritance (HP:0000006): A mode of inheritance that is observed for traits related to a gene encoded on one of the autosomes (i.e., the human chromosomes 1-22) in which a trait manifests in heterozygotes. In the context of medical genetics, an autosomal dominant disorder is caused when a single copy of the mutant allele is present. Males and females are affected equally, and can both transmit the disorder with a risk of 50% for each child of inheriting the mutant allele. Evidence: PCS. (PMID:28886343)
- Hypermetric saccades (HP:0007338): A saccade that overshoots the target with the dynamic saccade. Evidence: PCS. Frequency: 1/1. (PMID:28886343)
- Slowly progressive (HP:0003677): Applies to a disease manifestation that only slowly increases in scope or severity over the course of time. Evidence: PCS. (PMID:28886343)
- Brisk reflexes (HP:0001348): Tendon reflexes that are noticeably more active than usual (conventionally denoted 3+ on clinical examination). Brisk reflexes may or may not indicate a neurological lesion. They are distinguished from hyperreflexia by the fact that hyerreflexia is characterized by hyperactive repeating (clonic) reflexes, which are considered to be always abnormal. Evidence: PCS. Frequency: 1/7. (PMID:28886343)
These phenotypes are associated with the disease spinocerebellar ataxia 44 (OMIM:617691).